- Ectopia pupillae (HP:0009918): A malposition of the pupil owing to a developmental defect of the iris. Evidence: IEA. (OMIM:129750)
- Autosomal dominant inheritance (HP:0000006): A mode of inheritance that is observed for traits related to a gene encoded on one of the autosomes (i.e., the human chromosomes 1-22) in which a trait manifests in heterozygotes. In the context of medical genetics, an autosomal dominant disorder is caused when a single copy of the mutant allele is present. Males and females are affected equally, and can both transmit the disorder with a risk of 50% for each child of inheriting the mutant allele. Evidence: IEA. (OMIM:129750)
These phenotypes are associated with the disease ectopia pupillae (OMIM:129750).